Phenotypes associated with the disease Crisponi syndrome (ORPHA:1545):
- Narrow mouth (HP:0000160): Distance between the commissures of the mouth more than 2 SD below the mean. Alternatively, an apparently decreased width of the oral aperture (subjective). Evidence: TAS. Frequency: Occasional (HP:0040283). (ORPHA:1545)
- High palate (HP:0000218): Height of the palate more than 2 SD above the mean (objective) or palatal height at the level of the first permanent molar more than twice the height of the teeth (subjective). Evidence: TAS. Frequency: Frequent (HP:0040282). (ORPHA:1545)
- Full cheeks (HP:0000293): Increased prominence or roundness of soft tissues between zygomata and mandible. Evidence: TAS. Frequency: Very frequent (HP:0040281). (ORPHA:1545)
- Long philtrum (HP:0000343): Distance between nasal base and midline upper lip vermilion border more than 2 SD above the mean. Alternatively, an apparently increased distance between nasal base and midline upper lip vermilion border. Evidence: TAS. Frequency: Very frequent (HP:0040281). (ORPHA:1545)
- Micrognathia (HP:0000347): Developmental hypoplasia of the mandible. Evidence: TAS. Frequency: Occasional (HP:0040283). (ORPHA:1545)
- Wide nose (HP:0000445): Interalar distance more than two standard deviations above the mean for age, i.e., an apparently increased width of the nasal base and alae. Evidence: TAS. Frequency: Very frequent (HP:0040281). (ORPHA:1545)
- Anteverted nares (HP:0000463): Anteriorly-facing nostrils viewed with the head in the Frankfurt horizontal and the eyes of the observer level with the eyes of the subject. This gives the appearance of an upturned nose (upturned nasal tip). Evidence: TAS. Frequency: Very frequent (HP:0040281). (ORPHA:1545)
- Hypohidrosis (HP:0000966): Abnormally diminished capacity to sweat. Evidence: TAS. Frequency: Very frequent (HP:0040281). (ORPHA:1545)
- Hyperhidrosis (HP:0000975): Abnormal excessive perspiration (sweating) despite the lack of appropriate stimuli like hot and humid weather. Evidence: TAS. Frequency: Very frequent (HP:0040281). (ORPHA:1545)
- Seizure (HP:0001250): A seizure is an intermittent abnormality of nervous system physiology characterized by a transient occurrence of signs and/or symptoms due to abnormal excessive or synchronous neuronal activity in the brain. Evidence: TAS. Frequency: Occasional (HP:0040283). (ORPHA:1545)
- Hypertonia (HP:0001276): A condition in which there is increased muscle tone so that arms or legs, for example, are stiff and difficult to move. Evidence: TAS. Frequency: Very frequent (HP:0040281). (ORPHA:1545)
- Flexion contracture (HP:0001371): A flexion contracture is a bent (flexed) joint that cannot be straightened actively or passively. It is thus a chronic loss of joint motion due to structural changes in muscle, tendons, ligaments, or skin that prevents normal movement of joints. Evidence: TAS. Frequency: Very frequent (HP:0040281). (ORPHA:1545)
- Limitation of joint mobility (HP:0001376): A reduction in the freedom of movement of one or more joints. Evidence: TAS. Frequency: Frequent (HP:0040282). (ORPHA:1545)
- Death in infancy (HP:0001522): Death within the first 24 months of life. Evidence: TAS. Frequency: Very frequent (HP:0040281). (ORPHA:1545)
- Sudden cardiac death (HP:0001645): The heart suddenly and unexpectedly stops beating resulting in death within a short time period (generally within 1 h of symptom onset). Evidence: TAS. Frequency: Very frequent (HP:0040281). (ORPHA:1545)
- Malignant hyperthermia (HP:0002047): Malignant hyperthermia is characterized by a rapid increase in temperature to 39-42 degrees C. Malignant hyperthermia may occur in response to either inhalational anesthetics such as halothane, to muscle relaxants such as succinylcholine, or to exercise. Evidence: TAS. Frequency: Very frequent (HP:0040281). (ORPHA:1545)
- Respiratory insufficiency (HP:0002093). Evidence: TAS. Frequency: Very frequent (HP:0040281). (ORPHA:1545)
- Scoliosis (HP:0002650): The presence of an abnormal lateral curvature of the spine. Evidence: TAS. Frequency: Very frequent (HP:0040281). (ORPHA:1545)
- Kyphosis (HP:0002808): Exaggerated anterior convexity of the thoracic vertebral column. Evidence: TAS. Frequency: Very frequent (HP:0040281). (ORPHA:1545)
- Feeding difficulties (HP:0011968): Impaired ability to eat related to problems gathering food and getting ready to suck, chew, or swallow it. Evidence: TAS. Frequency: Very frequent (HP:0040281). (ORPHA:1545)
- Camptodactyly of finger (HP:0100490): The distal interphalangeal joint and/or the proximal interphalangeal joint of the fingers cannot be extended to 180 degrees by either active or passive extension. Evidence: TAS. Frequency: Very frequent (HP:0040281). (ORPHA:1545)
- Cognitive impairment (HP:0100543): Abnormal cognition is characterized by deficits in thinking, reasoning, or remembering. Evidence: TAS. Frequency: Frequent (HP:0040282). (ORPHA:1545)
- Large face (HP:0100729). Evidence: TAS. Frequency: Very frequent (HP:0040281). (ORPHA:1545)